- Dry skin (HP:0000958): Skin characterized by the lack of natural or normal moisture. Evidence: PCS. Frequency: 2/3. (PMID:27321946)
- Microdontia (HP:0000691): Decreased size of the teeth, which can be defined as a mesiodistal tooth diameter (width) more than 2 SD below mean. Alternatively, an apparently decreased maximum width of tooth. Evidence: PCS. Frequency: 3/3. (PMID:27321946)
- Selective tooth agenesis (HP:0001592): Agenesis specifically affecting one of the classes incisor, premolar, or molar. Evidence: PCS. Frequency: 3/3. (PMID:27321946)
- Sparse eyebrow (HP:0045075): Decreased density/number of eyebrow hairs. Evidence: PCS. Frequency: 3/3. (PMID:27321946)
- Autosomal dominant inheritance (HP:0000006): A mode of inheritance that is observed for traits related to a gene encoded on one of the autosomes (i.e., the human chromosomes 1-22) in which a trait manifests in heterozygotes. In the context of medical genetics, an autosomal dominant disorder is caused when a single copy of the mutant allele is present. Males and females are affected equally, and can both transmit the disorder with a risk of 50% for each child of inheriting the mutant allele. Evidence: PCS. (PMID:27321946)
- Sparse hair (HP:0008070): Reduced density of hairs. Evidence: PCS. Frequency: 2/3. (PMID:27321946)
These phenotypes are associated with the disease tooth agenesis, selective, 8 (OMIM:617073).